Phenotypes associated with the disease Yellow fever (ORPHA:99829):
- Fever (HP:0001945): Body temperature elevated above the normal range. Evidence: TAS. Frequency: Very frequent (HP:0040281). (ORPHA:99829)
- Nausea (HP:0002018): A sensation of unease in the stomach together with an urge to vomit. Evidence: TAS. Frequency: Very frequent (HP:0040281). (ORPHA:99829)
- Increased circulating IgM concentration (HP:0003496): An abnormally increased level of immunoglobulin M in blood. Evidence: TAS. Frequency: Very frequent (HP:0040281). (ORPHA:99829)
- Viremia (HP:0020071): The presence of virus in the blood. Evidence: TAS. Frequency: Very frequent (HP:0040281). (ORPHA:99829)
- Elevated circulating alanine aminotransferase concentration (HP:0031964): An abnormally high concentration in the circulation of alanine aminotransferase (ALT). Evidence: TAS. Frequency: Very frequent (HP:0040281). (ORPHA:99829)
- Renal insufficiency (HP:0000083): A reduction in the level of performance of the kidneys in areas of function comprising the concentration of urine, removal of wastes, the maintenance of electrolyte balance, homeostasis of blood pressure, and calcium metabolism. Evidence: TAS. Frequency: Frequent (HP:0040282). (ORPHA:99829)
- Bradycardia (HP:0001662): A slower than normal heart rate (in adults, slower than 60 beats per minute). Evidence: TAS. Frequency: Frequent (HP:0040282). (ORPHA:99829)
- Abnormal bleeding (HP:0001892): An abnormal susceptibility to bleeding, often referred to as a bleeding diathesis. A bleeding diathesis may be related to vascular, platelet and coagulation defects. Evidence: TAS. Frequency: Frequent (HP:0040282). (ORPHA:99829)
- Acute kidney injury (HP:0001919): Sudden loss of renal function, as manifested by decreased urine production, and a rise in serum creatinine or blood urea nitrogen concentration (azotemia). Evidence: TAS. Frequency: Frequent (HP:0040282). (ORPHA:99829)
- Metabolic acidosis (HP:0001942): Metabolic acidosis (MA) is characterized by a fall in blood pH due to a reduction of serum bicarbonate concentration. This can occur as a result of either the accumulation of acids (high anion gap MA) or the loss of bicarbonate from the gastrointestinal tract or the kidney (hyperchloremic MA). By definition, MA is not due to a respirary cause. Evidence: TAS. Frequency: Frequent (HP:0040282). (ORPHA:99829)
- Vomiting (HP:0002013): Forceful ejection of the contents of the stomach through the mouth by means of a series of involuntary spasmic contractions. Evidence: TAS. Frequency: Frequent (HP:0040282). (ORPHA:99829)
- Abdominal pain (HP:0002027): An unpleasant sensation characterized by physical discomfort (such as pricking, throbbing, or aching) and perceived to originate in the abdomen. Evidence: TAS. Frequency: Frequent (HP:0040282). (ORPHA:99829)
- Hematemesis (HP:0002248): The vomiting of blood. Evidence: TAS. Frequency: Frequent (HP:0040282). (ORPHA:99829)
- Headache (HP:0002315): Cephalgia, or pain sensed in various parts of the head, not confined to the area of distribution of any nerve. Evidence: TAS. Frequency: Frequent (HP:0040282). (ORPHA:99829)
- Arthralgia (HP:0002829): Joint pain. Evidence: TAS. Frequency: Frequent (HP:0040282). (ORPHA:99829)
- Elevated circulating creatine kinase activity (HP:0003236): The activity of creatine kinase in the blood circulation is above the upper limit of normal. Evidence: TAS. Frequency: Frequent (HP:0040282). (ORPHA:99829)
- Elevated circulating creatinine concentration (HP:0003259): An increased amount of creatinine in the blood. Evidence: TAS. Frequency: Frequent (HP:0040282). (ORPHA:99829)
- Myalgia (HP:0003326): Pain in muscle. Evidence: TAS. Frequency: Frequent (HP:0040282). (ORPHA:99829)
- Pancreatic hyperplasia (HP:0006277): Hyperplasia of the pancreas. Evidence: TAS. Frequency: Frequent (HP:0040282). (ORPHA:99829)
- Chills (HP:0025143): A sudden sensation of feeling cold. Evidence: TAS. Frequency: Frequent (HP:0040282). (ORPHA:99829)
- Excessive bleeding after a venipuncture (HP:0030139): An abnormal high amount of bleeding following the procedure of taking a blood sample. Evidence: TAS. Frequency: Frequent (HP:0040282). (ORPHA:99829)
- Increased circulating interleukin 6 concentration (HP:0030783): The concentration of interleukin-6 in the blood circulation is above the upper limit of normal. Evidence: TAS. Frequency: Frequent (HP:0040282). (ORPHA:99829)
- Elevated circulating aspartate aminotransferase concentration (HP:0031956): The concentration of aspartate aminotransferase (AST) in the blood circulation is above the upper limit of normal. Evidence: TAS. Frequency: Frequent (HP:0040282). (ORPHA:99829)
- Jaundice (HP:0000952): Yellow pigmentation of the skin due to bilirubin, which in turn is the result of increased bilirubin concentration in the bloodstream. Evidence: TAS. Frequency: Occasional (HP:0040283). (ORPHA:99829)
- Seizure (HP:0001250): A seizure is an intermittent abnormality of nervous system physiology characterized by a transient occurrence of signs and/or symptoms due to abnormal excessive or synchronous neuronal activity in the brain. Evidence: TAS. Frequency: Occasional (HP:0040283). (ORPHA:99829)
- Coma (HP:0001259): The complete absence of wakefulness and consciousness, which is evident through a lack of response to any form of external stimuli. Evidence: TAS. Frequency: Occasional (HP:0040283). (ORPHA:99829)
- Acute pancreatitis (HP:0001735): A acute form of pancreatitis. Evidence: TAS. Frequency: Occasional (HP:0040283). (ORPHA:99829)
- Thrombocytopenia (HP:0001873): A reduction in the number of circulating thrombocytes. Evidence: TAS. Frequency: Occasional (HP:0040283). (ORPHA:99829)
- Increased total leukocyte count (HP:0001974): An abnormal increase in the number of leukocytes in the blood. Evidence: TAS. Frequency: Occasional (HP:0040283). (ORPHA:99829)
- Diarrhea (HP:0002014): Abnormally increased frequency (usually defined as three or more) loose or watery bowel movements a day. Evidence: TAS. Frequency: Occasional (HP:0040283). (ORPHA:99829)
- Hyperbilirubinemia (HP:0002904): An increased amount of bilirubin in the blood. Evidence: TAS. Frequency: Occasional (HP:0040283). (ORPHA:99829)
- Reduced coagulation factor V activity (HP:0003225): Decreased activity of coagulation factor V. Evidence: TAS. Frequency: Occasional (HP:0040283). (ORPHA:99829)
- Low back pain (HP:0003419): An unpleasant sensation characterized by physical discomfort (such as pricking, throbbing, or aching) localized to the lower back. Evidence: TAS. Frequency: Occasional (HP:0040283). (ORPHA:99829)
- Supraventricular arrhythmia (HP:0005115): A type of arrhythmia that originates above the ventricles, whereby the electrical impulse propagates down the normal His Purkinje system similar to normal sinus rhythm. Evidence: TAS. Frequency: Occasional (HP:0040283). (ORPHA:99829)
- Prolonged prothrombin time (HP:0008151): Increased time to coagulation in the prothrombin time test, which is a measure of the extrinsic pathway of coagulation. The results of the prothrombin time test are often expressed in terms of the International normalized ratio (INR), which is calculated as a ratio of the patient's prothrombin time (PT) to a control PT standardized for the potency of the thromboplastin reagent developed by the World Health Organization (WHO) using the formula: INR is equal to Patient PT divided by Control PT. Evidence: TAS. Frequency: Occasional (HP:0040283). (ORPHA:99829)
- Increased total neutrophil count (HP:0011897): Abnormal increase of absolute number of neutrophils in the blood, per microliter, compared to a reference range for a given sex and age-group. Evidence: TAS. Frequency: Occasional (HP:0040283). (ORPHA:99829)
- Hypofibrinogenemia (HP:0011900): Decreased concentration of fibrinogen in the blood. Evidence: TAS. Frequency: Occasional (HP:0040283). (ORPHA:99829)
- Capillary leak (HP:0030005): An acute phenomenon characterized by hypotension and anasarca due to the loss of plasma volume into peripheral tissues, with evidence of decreased plasma volume (hemoconcentration) and protein loss from the intravascular space (hypoalbuminemia) during acute episodes. Evidence: TAS. Frequency: Occasional (HP:0040283). (ORPHA:99829)
- Shock (HP:0031273): The state in which profound and widespread reduction of effective tissue perfusion leads first to reversible, and then if prolonged, to irreversible cellular injury. Evidence: TAS. Frequency: Occasional (HP:0040283). (ORPHA:99829)
- Decreased serum bicarbonate concentration (HP:0032066): An abnormal reduction of the concentration of bicarbonate, HCO3[-], in the circulation. Evidence: TAS. Frequency: Occasional (HP:0040283). (ORPHA:99829)
- Skin rash (HP:0000988): A red eruption of the skin. Evidence: TAS. Frequency: Very rare (HP:0040284). (ORPHA:99829)
- Status epilepticus (HP:0002133): Status epilepticus is a type of prolonged seizure resulting either from the failure of the mechanisms responsible for seizure termination or from the initiation of mechanisms which lead to abnormally prolonged seizures (after time point t1). It is a condition that can have long-term consequences (after time point t2), including neuronal death, neuronal injury, and alteration of neuronal networks, depending on the type and duration of seizures. Evidence: TAS. Frequency: Very rare (HP:0040284). (ORPHA:99829)
- Increased intracranial pressure (HP:0002516): An increase of the pressure inside the cranium (skull) and thereby in the brain tissue and cerebrospinal fluid. Evidence: TAS. Frequency: Very rare (HP:0040284). (ORPHA:99829)
- Internal hemorrhage (HP:0011029): The presence of hemorrhage within the body. Evidence: TAS. Frequency: Very rare (HP:0040284). (ORPHA:99829)
- Reduced left ventricular ejection fraction (HP:0012664): A diminution of the volumetric fraction of blood pumped out of the ventricle with each cardiac cycle. Evidence: TAS. Frequency: Very rare (HP:0040284). (ORPHA:99829)
- Opportunistic infection (HP:0031690): An infection that is caused by a pathogen that would generally not be able to cause an infection in a host with a normal immune system. Such pathogens take advantage of the opportunity, so to speak, that is provided by a weakened immune system. Evidence: TAS. Frequency: Very rare (HP:0040284). (ORPHA:99829)
- Anuria (HP:0100519): Absence of urine, clinically classified as below 50ml/day. Evidence: TAS. Frequency: Very rare (HP:0040284). (ORPHA:99829)